Phenotypes associated with the disease immunodeficiency, X-linked, with deficiency of 115,000 Dalton surface glycoprotein (OMIM:308220):
- Recurrent protozoan infections (HP:0005386): Increased susceptibility to protozoan infections as manifested by recurrent episodes of protozoan infection. Evidence: PCS. (PMID:6499285)
- Recurrent bacterial infections (HP:0002718): Increased susceptibility to bacterial infections as manifested by recurrent episodes of bacterial infection. Evidence: PCS. (PMID:6499285)
- X-linked inheritance (HP:0001417): A mode of inheritance that is observed for traits related to a gene encoded on the X chromosome. Evidence: PCS. (PMID:6499285)
- Recurrent viral infections (HP:0004429): Increased susceptibility to viral infections as manifested by recurrent episodes of viral infection. Evidence: PCS. (PMID:6499285)
- Abnormal T cell physiology (HP:0011840): A functional anomaly of T cells. Evidence: PCS. (PMID:6499285)